- Delayed speech and language development (HP:0000750): A degree of language development that is significantly below the norm for a child of a specified age. Evidence: TAS. Frequency: Very frequent (HP:0040281). (ORPHA:2466)
- Intellectual disability (HP:0001249): The term intellectual disability or intellectual developmental disorder is used to describe significantly sub-average intellectual and adaptive functioning based on clinical assessment and as measured by individually administered, appropriately normed, standardized and validated tests of intellectual functioning and adaptive behavior, with onset during the developmental period from infancy through adolescence. Evidence: TAS. Frequency: Very frequent (HP:0040281). (ORPHA:2466)
- Hand clenching (HP:0001188): An abnormal hand posture in which the hands are clenched to fists. All digits held completely flexed at the metacarpophalangeal and interphalangeal joints. In prenatal sonography of the fetal clenched hand, the index finger overlaps a clenched fist formed by the other digits. The proximal interphalangeal articulation of the index finger is flexed and ulnarly deviated, and the thumb is adducted. Evidence: TAS. Frequency: Very frequent (HP:0040281). (ORPHA:2466)
- Spastic paraplegia (HP:0001258): Complete loss of the ability to move the lower limbs accompanied by spasticity of the lower limbs. Evidence: TAS. Frequency: Very frequent (HP:0040281). (ORPHA:2466)
- Agenesis of corpus callosum (HP:0001274): Absence of the corpus callosum as a result of the failure of the corpus callosum to develop, which can be the result of a failure in any one of the multiple steps of callosal development including cellular proliferation and migration, axonal growth or glial patterning at the midline. Evidence: TAS. Frequency: Occasional (HP:0040283). (ORPHA:2466)
- Gait disturbance (HP:0001288): The term gait disturbance can refer to any disruption of the ability to walk. Evidence: TAS. Frequency: Very frequent (HP:0040281). (ORPHA:2466)
- Hyperreflexia (HP:0001347): Hyperreflexia is the presence of hyperactive stretch reflexes of the muscles. Evidence: TAS. Frequency: Very frequent (HP:0040281). (ORPHA:2466)
- Ventriculomegaly (HP:0002119): An increase in size of the ventricular system of the brain. Evidence: TAS. Frequency: Occasional (HP:0040283). (ORPHA:2466)
- Aphasia (HP:0002381): An acquired language impairment of some or all of the abilities to produce or comprehend speech and to read or write. Evidence: TAS. Frequency: Very frequent (HP:0040281). (ORPHA:2466)
- Clinodactyly of the 5th finger (HP:0004209): Clinodactyly refers to a bending or curvature of the fifth finger in the radial direction (i.e., towards the 4th finger). Evidence: TAS. Frequency: Frequent (HP:0040282). (ORPHA:2466)
- Short stature (HP:0004322): A height below that which is expected according to age and gender norms. Although there is no universally accepted definition of short stature, many refer to "short stature" as height more than 2 standard deviations below the mean for age and gender (or below the 3rd percentile for age and gender dependent norms). Evidence: TAS. Frequency: Very frequent (HP:0040281). (ORPHA:2466)
- Hemiplegia/hemiparesis (HP:0004374): Loss of strength in the arm, leg, and sometimes face on one side of the body. Hemiplegia refers to a severe or complete loss of strength, whereas hemiparesis refers to a relatively mild loss of strength. Evidence: TAS. Frequency: Very frequent (HP:0040281). (ORPHA:2466)
- Camptodactyly of finger (HP:0100490): The distal interphalangeal joint and/or the proximal interphalangeal joint of the fingers cannot be extended to 180 degrees by either active or passive extension. Evidence: TAS. Frequency: Frequent (HP:0040282). (ORPHA:2466)
These phenotypes are associated with the disease MASA syndrome (ORPHA:2466).